- Autosomal recessive inheritance (HP:0000007): A mode of inheritance that is observed for traits related to a gene encoded on one of the autosomes (i.e., the human chromosomes 1-22) in which a trait manifests in individuals with two pathogenic alleles, either homozygotes (two copies of the same mutant allele) or compound heterozygotes (whereby each copy of a gene has a distinct mutant allele). Evidence: IEA. (OMIM:225100)
- Ectopia lentis (HP:0001083): Dislocation or malposition of the crystalline lens of the eye. A partial displacement (or dislocation) of the lens is described as a subluxation of the lens, while a complete displacement is termed luxation of the lens. A complete displacement occurs if the lens is completely outside the patellar fossa of the lens, either in the anterior chamber, in the vitreous, or directly on the retina. If the lens is partially displaced but still contained within the lens space, then it is termed subluxation. Evidence: IEA. (OMIM:225100)
These phenotypes are associated with the disease ectopia lentis 2, isolated, autosomal recessive (OMIM:225100).